Phenotypes associated with the disease cataract 1 multiple types (OMIM:116200):
- Nuclear cataract (HP:0100018): A nuclear cataract is an opacity or clouding that develops in the lens nucleus. That is, a nuclear cataract is one that is located in the center of the lens. The nucleus tends to darken changing from clear to yellow and sometimes brown. Evidence: PCS. Frequency: 10/10. (PMID:10480374)
- Congenital onset (HP:0003577): A phenotypic abnormality that is present at birth. Evidence: PCS. Frequency: 10/10. (PMID:10480374)
- Pulverulent cataract (HP:0010693): A kind of congenital cataract that is characterized by a hollow sphere of punctate opacities involving the fetal nucleus and that usually occurs bilaterally. Evidence: PCS. Frequency: 10/10. Onset: Congenital onset (HP:0003577). (PMID:10480374)
- Microcornea (HP:0000482): A congenital abnormality of the cornea in which the cornea and the anterior segment of the eye are smaller than normal. The horizontal diameter of the cornea does not reach 10 mm even in adulthood. Evidence: TAS. Frequency: Occasional (HP:0040283). (OMIM:116200)
- Posterior subcapsular cataract (HP:0007787): A type of cataract affecting the posterior pole of lens immediately adjacent to ('beneath') the Lens capsule. Evidence: TAS. (OMIM:116200)
- Autosomal dominant inheritance (HP:0000006): A mode of inheritance that is observed for traits related to a gene encoded on one of the autosomes (i.e., the human chromosomes 1-22) in which a trait manifests in heterozygotes. In the context of medical genetics, an autosomal dominant disorder is caused when a single copy of the mutant allele is present. Males and females are affected equally, and can both transmit the disorder with a risk of 50% for each child of inheriting the mutant allele. Evidence: PCS. (PMID:10480374)